- Renal dysplasia (HP:0000110): The presence of developmental dysplasia of the kidney. Evidence: TAS. (OMIM:601331)
- Vesicoureteral reflux (HP:0000076): Abnormal (retrograde) movement of urine from the bladder into ureters or kidneys related to inadequacy of the valvular mechanism at the ureterovesicular junction or other causes. Evidence: TAS. Frequency: Occasional (HP:0040283). (OMIM:601331)
- Antenatal onset (HP:0030674): Onset prior to birth. Evidence: PCS. (PMID:23374899)
- Renal insufficiency (HP:0000083): A reduction in the level of performance of the kidneys in areas of function comprising the concentration of urine, removal of wastes, the maintenance of electrolyte balance, homeostasis of blood pressure, and calcium metabolism. Evidence: TAS. (OMIM:601331)
- Hyperechogenic kidneys (HP:0004719): An increase in amplitude of waves returned in ultrasonography of the kidney, which is generally displayed as increased brightness of the signal. Evidence: TAS. (OMIM:601331)
- Cystic renal dysplasia (HP:0000800). Evidence: TAS. (OMIM:601331)
- Autosomal dominant inheritance (HP:0000006): A mode of inheritance that is observed for traits related to a gene encoded on one of the autosomes (i.e., the human chromosomes 1-22) in which a trait manifests in heterozygotes. In the context of medical genetics, an autosomal dominant disorder is caused when a single copy of the mutant allele is present. Males and females are affected equally, and can both transmit the disorder with a risk of 50% for each child of inheriting the mutant allele. Evidence: TAS. (OMIM:601331)
These phenotypes are associated with the disease renal dysplasia, cystic, susceptibility to (OMIM:601331).